Phenotypes associated with the disease pseudopseudohypoparathyroidism (OMIM:612463):
- Delayed eruption of teeth (HP:0000684): Delayed tooth eruption, which can be defined as tooth eruption more than 2 SD beyond the mean eruption age. Evidence: IEA. (OMIM:612463)
- Brachydactyly (HP:0001156): Digits that appear disproportionately short compared to the hand/foot. The word brachydactyly is used here to describe a series distinct patterns of shortened digits (brachydactyly types A-E). This is the sense used here. Evidence: IEA. (OMIM:612463)
- Short stature (HP:0004322): A height below that which is expected according to age and gender norms. Although there is no universally accepted definition of short stature, many refer to "short stature" as height more than 2 standard deviations below the mean for age and gender (or below the 3rd percentile for age and gender dependent norms). Evidence: IEA. (OMIM:612463)
- Full cheeks (HP:0000293): Increased prominence or roundness of soft tissues between zygomata and mandible. Evidence: IEA. (OMIM:612463)
- Short neck (HP:0000470): Diminished length of the neck. Evidence: IEA. (OMIM:612463)
- Short metacarpal (HP:0010049): Diminished length of one or more metacarpal bones in relation to the others of the same hand or to the contralateral metacarpal. Evidence: IEA. (OMIM:612463)
- Depressed nasal bridge (HP:0005280): Posterior positioning of the nasal root in relation to the overall facial profile for age. Evidence: IEA. (OMIM:612463)
- Short metatarsal (HP:0010743): Diminished length of a metatarsal bone, with resultant proximal displacement of the associated toe. Evidence: IEA. (OMIM:612463)
- Osteoporosis (HP:0000939): Osteoporosis is a systemic skeletal disease characterized by low bone density and microarchitectural deterioration of bone tissue with a consequent increase in bone fragility. According to the WHO criteria, osteoporosis is defined as a BMD that lies 2.5 standard deviations or more below the average value for young healthy adults (a T-score below -2.5 SD). Evidence: IEA. (OMIM:612463)
- Cognitive impairment (HP:0100543): Abnormal cognition is characterized by deficits in thinking, reasoning, or remembering. Evidence: IEA. (OMIM:612463)
- Cataract (HP:0000518): A cataract is an opacity or clouding that develops in the crystalline lens of the eye or in its capsule. Evidence: IEA. (OMIM:612463)
- Nystagmus (HP:0000639): Rhythmic, involuntary oscillations of one or both eyes related to abnormality in fixation, conjugate gaze, or vestibular mechanisms. Evidence: IEA. (OMIM:612463)
- Enamel hypoplasia (HP:0006297): Developmental hypoplasia of the dental enamel. Evidence: IEA. (OMIM:612463)
- Round face (HP:0000311): The facial appearance is more circular than usual as viewed from the front. Evidence: IEA. (OMIM:612463)
- Autosomal dominant inheritance (HP:0000006): A mode of inheritance that is observed for traits related to a gene encoded on one of the autosomes (i.e., the human chromosomes 1-22) in which a trait manifests in heterozygotes. In the context of medical genetics, an autosomal dominant disorder is caused when a single copy of the mutant allele is present. Males and females are affected equally, and can both transmit the disorder with a risk of 50% for each child of inheriting the mutant allele. Evidence: PCS. (PMID:2122458)
- Obesity (HP:0001513): Accumulation of substantial excess body fat. Evidence: IEA. (OMIM:612463)
- Intellectual disability (HP:0001249): The term intellectual disability or intellectual developmental disorder is used to describe significantly sub-average intellectual and adaptive functioning based on clinical assessment and as measured by individually administered, appropriately normed, standardized and validated tests of intellectual functioning and adaptive behavior, with onset during the developmental period from infancy through adolescence. Evidence: TAS. Frequency: Occasional (HP:0040283). (OMIM:612463)
- Pseudohypoparathyroidism (HP:0000852): A condition characterized by resistance to the action of parathyroid hormone, in which there is hypocalcemia, hyperphosphatemia, and (appropriately) high levels of parathyroid hormone. Evidence: IEA. (OMIM:612463)